Phenotypes associated with the disease celiac trunk compression syndrome (OMIM:116870):
- Celiac artery compression (HP:0012327): Compression of the celiac artery. Evidence: TAS. (OMIM:116870)
- Autosomal dominant inheritance (HP:0000006): A mode of inheritance that is observed for traits related to a gene encoded on one of the autosomes (i.e., the human chromosomes 1-22) in which a trait manifests in heterozygotes. In the context of medical genetics, an autosomal dominant disorder is caused when a single copy of the mutant allele is present. Males and females are affected equally, and can both transmit the disorder with a risk of 50% for each child of inheriting the mutant allele. Evidence: TAS. (OMIM:116870)
- Abdominal pain (HP:0002027): An unpleasant sensation characterized by physical discomfort (such as pricking, throbbing, or aching) and perceived to originate in the abdomen. Evidence: TAS. (OMIM:116870)